- Focal impaired awareness seizure (HP:0002384): Focal impaired awareness seizure (or focal seizure with impaired or lost awareness) is a type of focal-onset seizure characterized by some degree (which may be partial) of impairment of the person's awareness of themselves or their surroundings at any point during the seizure. Evidence: TAS. (OMIM:611631)
- Migraine with aura (HP:0002077): A type of migraine in which there is an aura characterized by focal neurological phenomena that usually proceed, but may accompany or occur in the absence of, the headache. The symptoms of an aura may include fully reversible visual, sensory, and speech symptoms but not motor weakness. Visual symptoms may include flickering lights, spots and lines and/or loss of vision and/or unilateral sensory symptoms such as paresthesias or numbness. At least one of the symptoms of an aura develops gradually over 5 or more minutes and/or different symptoms occur in succession. Evidence: TAS. (OMIM:611631)
- Focal sensory seizure with visual features (HP:0011165): A seizure characterized by elementary visual hallucinations such as flashing or flickering lights/colors, or other shapes, simple patterns, scotomata, or amaurosis as its first clinical manifestation. Evidence: TAS. (OMIM:611631)
- Typified by incomplete penetrance (HP:0003829): Description of conditions in which not all individuals with a given genotype exhibit the disease. Penetrance is the proportion that develop disease given a lifespan of 80 years. Evidence: TAS. (OMIM:611631)
- Auditory hallucination (HP:0008765): Perception of sounds without auditory stimulus. Evidence: TAS. (OMIM:611631)
- Focal aware seizure (HP:0002349): A type of focal-onset seizure in which awareness is preserved. Awareness during a seizure is defined as the patient being fully aware of themself and their environment throughout the seizure, even if immobile. Evidence: TAS. (OMIM:611631)
- Autosomal dominant inheritance (HP:0000006): A mode of inheritance that is observed for traits related to a gene encoded on one of the autosomes (i.e., the human chromosomes 1-22) in which a trait manifests in heterozygotes. In the context of medical genetics, an autosomal dominant disorder is caused when a single copy of the mutant allele is present. Males and females are affected equally, and can both transmit the disorder with a risk of 50% for each child of inheriting the mutant allele. Evidence: TAS. (OMIM:611631)
These phenotypes are associated with the disease familial temporal lobe epilepsy 4 (OMIM:611631).